- Axial hypotonia (HP:0008936): Muscular hypotonia (abnormally low muscle tone) affecting the musculature of the trunk. Evidence: TAS. Frequency: Occasional (HP:0040283). (OMIM:614526)
- Facial hypotonia (HP:0000297): Reduced muscle tone of a muscle that is innervated by the facial nerve (the seventh cranial nerve). Evidence: TAS. Frequency: Occasional (HP:0040283). (OMIM:614526)
- Downslanted palpebral fissures (HP:0000494): The palpebral fissure inclination is more than two standard deviations below the mean. Evidence: TAS. Frequency: Occasional (HP:0040283). (OMIM:614526)
- Brachydactyly (HP:0001156): Digits that appear disproportionately short compared to the hand/foot. The word brachydactyly is used here to describe a series distinct patterns of shortened digits (brachydactyly types A-E). This is the sense used here. Evidence: TAS. Frequency: Occasional (HP:0040283). (OMIM:614526)
- Esophageal atresia (HP:0002032): A developmental defect resulting in complete obliteration of the lumen of the esophagus such that the esophagus ends in a blind pouch rather than connecting to the stomach. Evidence: TAS. Frequency: Occasional (HP:0040283). (OMIM:614526)
- Seizure (HP:0001250): A seizure is an intermittent abnormality of nervous system physiology characterized by a transient occurrence of signs and/or symptoms due to abnormal excessive or synchronous neuronal activity in the brain. Evidence: TAS. Frequency: Occasional (HP:0040283). (OMIM:614526)
- Deeply set eye (HP:0000490): An eye that is more deeply recessed into the plane of the face than is typical. Evidence: TAS. Frequency: Occasional (HP:0040283). (OMIM:614526)
- Cleft soft palate (HP:0000185): Cleft of the soft palate (also known as the velum, or muscular palate) as a result of a developmental defect occurring between the 7th and 12th week of pregnancy. Cleft soft palate can cause functional abnormalities of the Eustachian tube with resulting middle ear anomalies and hearing difficulties, as well as speech problems associated with hypernasal speech due to velopharyngeal insufficiency. Evidence: TAS. Frequency: Occasional (HP:0040283). (OMIM:614526)
- Broad thumb (HP:0011304): Increased thumb width without increased dorso-ventral dimension. Evidence: TAS. Frequency: Occasional (HP:0040283). (OMIM:614526)
- Smooth philtrum (HP:0000319): Flat skin surface, with no ridge formation in the central region of the upper lip between the nasal base and upper vermilion border. Evidence: TAS. Frequency: Occasional (HP:0040283). (OMIM:614526)
- Microphthalmia (HP:0000568): A developmental anomaly characterized by abnormal smallness of one or both eyes. Evidence: TAS. Frequency: Occasional (HP:0040283). (OMIM:614526)
- Peters anomaly (HP:0000659): A form of anterior segment dysgenesis in which abnormal cleavage of the anterior chamber occurs. Peters anomaly is characterized by central, paracentral, or complete corneal opacity. Evidence: TAS. Frequency: Occasional (HP:0040283). (OMIM:614526)
- Atrial septal defect (HP:0001631): Atrial septal defect (ASD) is a congenital abnormality of the interatrial septum that enables blood flow between the left and right atria via the interatrial septum. Evidence: TAS. Frequency: Occasional (HP:0040283). (OMIM:614526)
- Autosomal dominant inheritance (HP:0000006): A mode of inheritance that is observed for traits related to a gene encoded on one of the autosomes (i.e., the human chromosomes 1-22) in which a trait manifests in heterozygotes. In the context of medical genetics, an autosomal dominant disorder is caused when a single copy of the mutant allele is present. Males and females are affected equally, and can both transmit the disorder with a risk of 50% for each child of inheriting the mutant allele. Evidence: TAS. (OMIM:614526)
- Intellectual disability (HP:0001249): The term intellectual disability or intellectual developmental disorder is used to describe significantly sub-average intellectual and adaptive functioning based on clinical assessment and as measured by individually administered, appropriately normed, standardized and validated tests of intellectual functioning and adaptive behavior, with onset during the developmental period from infancy through adolescence. Evidence: TAS. (OMIM:614526)
- Glaucoma (HP:0000501): Glaucoma refers loss of retinal ganglion cells in a characteristic pattern of optic neuropathy usually associated with increased intraocular pressure. Evidence: TAS. Frequency: Occasional (HP:0040283). (OMIM:614526)
- Micrognathia (HP:0000347): Developmental hypoplasia of the mandible. Evidence: TAS. Frequency: Occasional (HP:0040283). (OMIM:614526)
- Triangular face (HP:0000325): Facial contour, as viewed from the front, triangular in shape, with breadth at the temples and tapering to a narrow chin. Evidence: TAS. Frequency: Occasional (HP:0040283). (OMIM:614526)
These phenotypes are associated with the disease chromosome 17q12 duplication syndrome (OMIM:614526).